- Opacification of the corneal stroma (HP:0007759): Reduced transparency of the stroma of cornea. Evidence: IEA. (OMIM:271310)
- Corneal stromal edema (HP:0012040): Abnormal accumulation of fluid and swelling of the stroma of cornea. Evidence: TAS. (OMIM:271310)
- Corneal dystrophy (HP:0001131): The term corneal dystrophy embraces a heterogenous group of bilateral genetically determined non-inflammatory corneal diseases that are restricted to the cornea. Evidence: IEA. (OMIM:271310)
- Severely reduced visual acuity (HP:0001141): Severe reduction of the ability to see. On the 6m visual acuity scale, severe reduction is defined as less than 6/60 but at least 3/60. On the 20ft visual acuity scale, severe reduction is defined as less than 20/200 but at least 20/400. On the decimal visual acuity scale, severe reduction is defined as less than 0.1 but at least 0.05. Evidence: IEA. (OMIM:271310)
- Ataxia (HP:0001251): Ataxia refers to impaired coordination of voluntary muscle movement. Cerebellar ataxia refers to ataxia due to dysfunction of the cerebellum. This causes a variety of elementary neurological deficits including asynergy (lack of coordination between muscles, limbs and joints), dysmetria (lack of ability to judge distances that can lead to under- or overshoot in grasping movements), and dysdiadochokinesia (inability to perform rapid movements requiring antagonizing muscle groups to be switched on and off repeatedly). Evidence: IEA. (OMIM:271310)
- Autosomal recessive inheritance (HP:0000007): A mode of inheritance that is observed for traits related to a gene encoded on one of the autosomes (i.e., the human chromosomes 1-22) in which a trait manifests in individuals with two pathogenic alleles, either homozygotes (two copies of the same mutant allele) or compound heterozygotes (whereby each copy of a gene has a distinct mutant allele). Evidence: IEA. (OMIM:271310)
- Spinocerebellar tract degeneration (HP:0002503). Evidence: IEA. (OMIM:271310)
- Intellectual disability (HP:0001249): The term intellectual disability or intellectual developmental disorder is used to describe significantly sub-average intellectual and adaptive functioning based on clinical assessment and as measured by individually administered, appropriately normed, standardized and validated tests of intellectual functioning and adaptive behavior, with onset during the developmental period from infancy through adolescence. Evidence: IEA. (OMIM:271310)
These phenotypes are associated with the disease corneal-cerebellar syndrome (OMIM:271310).